Phenotypes associated with the disease autosomal recessive nonsyndromic hearing loss 32 (OMIM:608653):
- Congenital onset (HP:0003577): A phenotypic abnormality that is present at birth. Evidence: PCS. Frequency: 7/7. (PMID:27259055)
- Sensorineural hearing impairment (HP:0000407): A type of hearing impairment in one or both ears related to an abnormal functionality of the cochlear nerve. Evidence: PCS. Frequency: 7/7. Onset: Congenital onset (HP:0003577). (PMID:27259055)
- Sensorineural hearing impairment (HP:0000407): A type of hearing impairment in one or both ears related to an abnormal functionality of the cochlear nerve. Evidence: PCS. Onset: Juvenile onset (HP:0003621). (PMID:27259055)
- Male infertility (HP:0003251). Evidence: PCS. Frequency: 5/8. (PMID:27259055)
- Autosomal recessive inheritance (HP:0000007): A mode of inheritance that is observed for traits related to a gene encoded on one of the autosomes (i.e., the human chromosomes 1-22) in which a trait manifests in individuals with two pathogenic alleles, either homozygotes (two copies of the same mutant allele) or compound heterozygotes (whereby each copy of a gene has a distinct mutant allele). Evidence: PCS. (PMID:27259055)
- Immotile sperm (HP:0012208): A lack of mobility of ejaculated sperm. Evidence: PCS. (PMID:27259055)
- Abnormal sperm morphology (HP:0012864): A structural anomaly of sperm. Evidence: PCS. Frequency: 4/4. (PMID:27259055)